Phenotypes associated with the disease Contractures-ectodermal dysplasia-cleft lip/palate syndrome (ORPHA:1484):
- Cleft palate (HP:0000175): Cleft palate is a developmental defect of the palate resulting from a failure of fusion of the palatine processes and manifesting as a separation of the roof of the mouth (soft and hard palate). Evidence: TAS. Frequency: Very frequent (HP:0040281). (ORPHA:1484)
- Lacrimation abnormality (HP:0000632): Abnormality of tear production. Evidence: TAS. Frequency: Very frequent (HP:0040281). (ORPHA:1484)
- Hypohidrosis (HP:0000966): Abnormally diminished capacity to sweat. Evidence: TAS. Frequency: Very frequent (HP:0040281). (ORPHA:1484)
- Global developmental delay (HP:0001263): A delay in the achievement of motor or mental milestones in the domains of development of a child, including motor skills, speech and language, cognitive skills, and social and emotional skills. This term should only be used to describe children younger than five years of age. Evidence: TAS. Frequency: Very frequent (HP:0040281). (ORPHA:1484)
- Limitation of joint mobility (HP:0001376): A reduction in the freedom of movement of one or more joints. Evidence: TAS. Frequency: Very frequent (HP:0040281). (ORPHA:1484)
- Arthrogryposis multiplex congenita (HP:0002804): Multiple congenital contractures in different body areas. Evidence: TAS. Frequency: Very frequent (HP:0040281). (ORPHA:1484)
- Non-midline cleft of the upper lip (HP:0100335): Clefting (gap or groove) of the upper lip affecting the lateral portions of the upper lip rather than the midline/median region. Evidence: TAS. Frequency: Very frequent (HP:0040281). (ORPHA:1484)
- Cognitive impairment (HP:0100543): Abnormal cognition is characterized by deficits in thinking, reasoning, or remembering. Evidence: TAS. Frequency: Very frequent (HP:0040281). (ORPHA:1484)